- Parkinsonism (HP:0001300): Characteristic neurologic anomaly resulting from degeneration of dopamine-generating cells in the substantia nigra, a region of the midbrain, characterized clinically by shaking, rigidity, slowness of movement and difficulty with walking and gait. Evidence: TAS. Frequency: Very frequent (HP:0040281). (ORPHA:238455)
- Dystonia (HP:0001332): An abnormally increased muscular tone that causes fixed abnormal postures. There is a slow, intermittent twisting motion that leads to exaggerated turning and posture of the extremities and trunk. Evidence: TAS. Frequency: Very frequent (HP:0040281). (ORPHA:238455)
- Hypomimic face (HP:0000338): A reduced degree of motion of the muscles beneath the skin of the face, often associated with reduced facial crease formation. Evidence: TAS. Frequency: Frequent (HP:0040282). (ORPHA:238455)
- Irritability (HP:0000737): An emotional state characterized by negative feelings of heightened frustration, annoyance, or feeling upset, often triggered by internal factors (e.g., fatigue, hunger, unfulfilled desires) or external factors (e.g., social or environmental challenges). Irritability may be unpredictable, and is accompanied by a lowered threshold for emotional reactivity and observable features (speech, facial expressions, or psychomotor activity). Evidence: TAS. Frequency: Frequent (HP:0040282). (ORPHA:238455)
- Global developmental delay (HP:0001263): A delay in the achievement of motor or mental milestones in the domains of development of a child, including motor skills, speech and language, cognitive skills, and social and emotional skills. This term should only be used to describe children younger than five years of age. Evidence: TAS. Frequency: Frequent (HP:0040282). (ORPHA:238455)
- Hypertonia (HP:0001276): A condition in which there is increased muscle tone so that arms or legs, for example, are stiff and difficult to move. Evidence: TAS. Frequency: Frequent (HP:0040282). (ORPHA:238455)
- Absent speech (HP:0001344): Complete lack of development of speech and language abilities. Evidence: TAS. Frequency: Frequent (HP:0040282). (ORPHA:238455)
- Constipation (HP:0002019): Infrequent or difficult evacuation of feces. Evidence: TAS. Frequency: Frequent (HP:0040282). (ORPHA:238455)
- Gastroesophageal reflux (HP:0002020): A condition in which the stomach contents leak backwards from the stomach into the esophagus through the lower esophageal sphincter. Evidence: TAS. Frequency: Frequent (HP:0040282). (ORPHA:238455)
- Bradykinesia (HP:0002067): Bradykinesia literally means slow movement, and is used clinically to denote a slowness in the execution of movement (in contrast to hypokinesia, which is used to refer to slowness in the initiation of movement). Evidence: TAS. Frequency: Frequent (HP:0040282). (ORPHA:238455)
- Chorea (HP:0002072): Chorea (Greek for 'dance') refers to widespread arrhythmic involuntary movements of a forcible, jerky and restless fashion. It is a random-appearing sequence of one or more discrete involuntary movements or movement fragments. Movements appear random because of variability in timing, duration or location. Each movement may have a distinct start and end. However, movements may be strung together and thus may appear to flow randomly from one muscle group to another. Chorea can involve the trunk, neck, face, tongue, and extremities. Evidence: TAS. Frequency: Frequent (HP:0040282). (ORPHA:238455)
- Orofacial dyskinesia (HP:0002310). Evidence: TAS. Frequency: Frequent (HP:0040282). (ORPHA:238455)
- Hypokinesia (HP:0002375): Abnormally diminished motor activity. In contrast to paralysis, hypokinesia is not characterized by a lack of motor strength, but rather by a poverty of movement. The typical habitual movements (e.g., folding the arms, crossing the legs) are reduced in frequency. Evidence: TAS. Frequency: Frequent (HP:0040282). (ORPHA:238455)
- Limb hypertonia (HP:0002509). Evidence: TAS. Frequency: Frequent (HP:0040282). (ORPHA:238455)
- Abnormal circulating carboxylic acid concentration (HP:0004354): Any deviation from the normal concentration of carboxylic acid in the blood circulation. Evidence: TAS. Frequency: Frequent (HP:0040282). (ORPHA:238455)
- Abnormal pyramidal sign (HP:0007256): Functional neurological abnormalities related to dysfunction of the pyramidal tract. Evidence: TAS. Frequency: Frequent (HP:0040282). (ORPHA:238455)
- Axial hypotonia (HP:0008936): Muscular hypotonia (abnormally low muscle tone) affecting the musculature of the trunk. Evidence: TAS. Frequency: Frequent (HP:0040282). (ORPHA:238455)
- Oculogyric crisis (HP:0010553): An acute dystonic reaction with blepharospasm, periorbital twitches, and protracted fixed staring episodes. There may be a maximal upward deviation of the eyes in the sustained fashion. Oculogyric crisis can be triggered by a number of factors including neuroleptic medications. Evidence: TAS. Frequency: Frequent (HP:0040282). (ORPHA:238455)
- Feeding difficulties (HP:0011968): Impaired ability to eat related to problems gathering food and getting ready to suck, chew, or swallow it. Evidence: TAS. Frequency: Frequent (HP:0040282). (ORPHA:238455)
- Cerebral palsy (HP:0100021): Cerebral palsy describes a group of permanent disorders of the development of movement and posture, causing activity limitation, that are attributed to nonprogressive disturbances that occurred in the developing fetal or infant brain. The motor disorders of cerebral palsy are often accompanied by disturbances of sensation, perception, cognition, communication, and behavior, by epilepsy, and by secondary musculoskeletal problems. Evidence: TAS. Frequency: Frequent (HP:0040282). (ORPHA:238455)
These phenotypes are associated with the disease Infantile dystonia-parkinsonism (ORPHA:238455).